Phenotypes associated with the disease Polyarteritis nodosa (ORPHA:767):
- Abnormal skin morphology (HP:0011121): Any morphological abnormality of the skin. Evidence: TAS. Frequency: Very frequent (HP:0040281). (ORPHA:767)
- Abnormality of the kidney (HP:0000077): An abnormality of the kidney. Evidence: TAS. Frequency: Frequent (HP:0040282). (ORPHA:767)
- Weight loss (HP:0001824): Reduction of total body weight. Evidence: TAS. Frequency: Frequent (HP:0040282). (ORPHA:767)
- Fever (HP:0001945): Body temperature elevated above the normal range. Evidence: TAS. Frequency: Frequent (HP:0040282). (ORPHA:767)
- Arthralgia (HP:0002829): Joint pain. Evidence: TAS. Frequency: Frequent (HP:0040282). (ORPHA:767)
- Myalgia (HP:0003326): Pain in muscle. Evidence: TAS. Frequency: Frequent (HP:0040282). (ORPHA:767)
- Polyarticular arthritis (HP:0005764). Evidence: TAS. Frequency: Frequent (HP:0040282). (ORPHA:767)
- Peripheral neuropathy (HP:0009830): Peripheral neuropathy is a general term for any disorder of the peripheral nervous system. The main clinical features used to classify peripheral neuropathy are distribution, type (mainly demyelinating versus mainly axonal), duration, and course. Evidence: TAS. Frequency: Frequent (HP:0040282). (ORPHA:767)
- Elevated circulating C-reactive protein concentration (HP:0011227): The concentration of C-reactive protein in the blood circulation is above the upper limit of normal. Evidence: TAS. Frequency: Frequent (HP:0040282). (ORPHA:767)
- Polyneuritis (HP:0031003): Simultaneous inflammation of multiple nerves. Evidence: TAS. Frequency: Frequent (HP:0040282). (ORPHA:767)
- Livedo racemosa (HP:0033260): Livedo racemosa describes a reddish-blue mottling of the skin in an irregular, reticular pattern. It differs from the more common livedo reticularis by its shape. Livedo racemosa consists of broken circular segments resulting in a seemingly larger pattern, as opposed to the fine, regular, complete network of livedo reticularis. Livedo racemosa results from permanent impairment of peripheral blood flow and, unlike livedo reticularis, it persists on warming. Evidence: TAS. Frequency: Frequent (HP:0040282). (ORPHA:767)
- Abnormality of the nervous system (HP:0000707): An abnormality of the nervous system. Evidence: TAS. Frequency: Occasional (HP:0040283). (ORPHA:767)
- Hypertension (HP:0000822): The presence of chronic increased pressure in the systemic arterial system. Evidence: TAS. Frequency: Occasional (HP:0040283). (ORPHA:767)
- Cutis marmorata (HP:0000965): A reticular discoloration of the skin with cyanotic (reddish-blue appearing) areas surrounding pale central areas due to dilation of capillary blood vessels and stagnation of blood within the vessels. Cutis marmorata generally occurs on the legs, arms and trunk and is often more severe in cold weather. Evidence: TAS. Frequency: Occasional (HP:0040283). (ORPHA:767)
- Subcutaneous nodule (HP:0001482): Slightly elevated lesions on or in the skin with a diameter of over 5 mm. Evidence: TAS. Frequency: Occasional (HP:0040283). (ORPHA:767)
- Pericarditis (HP:0001701): Inflammation of the sac-like covering around the heart (pericardium). Evidence: TAS. Frequency: Occasional (HP:0040283). (ORPHA:767)
- Morphological central nervous system abnormality (HP:0002011): A structural abnormality of the central nervous system. Evidence: TAS. Frequency: Occasional (HP:0040283). (ORPHA:767)
- Abdominal pain (HP:0002027): An unpleasant sensation characterized by physical discomfort (such as pricking, throbbing, or aching) and perceived to originate in the abdomen. Evidence: TAS. Frequency: Occasional (HP:0040283). (ORPHA:767)
- Abnormal lung morphology (HP:0002088): Any structural anomaly of the lung. Evidence: TAS. Frequency: Occasional (HP:0040283). (ORPHA:767)
- Sensory axonal neuropathy (HP:0003390): An axonal neuropathy of peripheral sensory nerves. Evidence: TAS. Frequency: Occasional (HP:0040283). (ORPHA:767)
- Erythema (HP:0010783): Redness of the skin, caused by hyperemia of the capillaries in the lower layers of the skin. Evidence: TAS. Frequency: Occasional (HP:0040283). (ORPHA:767)
- Abnormality of the gastrointestinal tract (HP:0011024): An abnormality of the gastrointestinal tract. Evidence: TAS. Frequency: Occasional (HP:0040283). (ORPHA:767)
- Abnormal cardiovascular system morphology (HP:0030680): Any structural anomaly of the heart and blood vessels. Evidence: TAS. Frequency: Occasional (HP:0040283). (ORPHA:767)
- Raynaud phenomenon (HP:0030880). Evidence: TAS. Frequency: Occasional (HP:0040283). (ORPHA:767)
- Skin ulcer (HP:0200042): A discontinuity of the skin exhibiting complete loss of the epidermis and often portions of the dermis and even subcutaneous fat. Evidence: TAS. Frequency: Occasional (HP:0040283). (ORPHA:767)
- Abnormality of the eye (HP:0000478): Any abnormality of the eye, including location, spacing, and intraocular abnormalities. Evidence: TAS. Frequency: Very rare (HP:0040284). (ORPHA:767)
- Cardiomyopathy (HP:0001638): A myocardial disorder in which the heart muscle is structurally and functionally abnormal, in the absence of coronary artery disease, hypertension, valvular disease and congenital heart disease sufficient to cause the observed myocardial abnormality. Evidence: TAS. Frequency: Very rare (HP:0040284). (ORPHA:767)
- Pleuritis (HP:0002102): Inflammation of the pleura. Evidence: TAS. Frequency: Very rare (HP:0040284). (ORPHA:767)